- Childhood onset (HP:0011463): Onset of disease at the age of between 1 and 5 years. Evidence: PCS. (PMID:37972748)
- Band-shaped corneal dystrophy (HP:0007709): A type of genetically determined disease of the cornea with corneal lesions with a band-like shape. Evidence: PCS. (PMID:37972748)
- Autosomal dominant inheritance (HP:0000006): A mode of inheritance that is observed for traits related to a gene encoded on one of the autosomes (i.e., the human chromosomes 1-22) in which a trait manifests in heterozygotes. In the context of medical genetics, an autosomal dominant disorder is caused when a single copy of the mutant allele is present. Males and females are affected equally, and can both transmit the disorder with a risk of 50% for each child of inheriting the mutant allele. Evidence: PCS. (PMID:37972748)
These phenotypes are associated with the disease Lisch epithelial corneal dystrophy (OMIM:620763).